- Impaired mastication (HP:0005216): An abnormal reduction in the ability to masticate (chew), i.e., in the ability to crush and ground food in preparation for swallowing. Evidence: TAS. (OMIM:614688)
- Pontine tegmental cap (HP:0030975): An abnormal curved or vaulted (capped) structure covering the middle third of the dorsal pontine tegmentum and projecting into the fourth ventricle. Evidence: TAS. (OMIM:614688)
- Facial palsy (HP:0010628): Facial nerve palsy is a dysfunction of cranial nerve VII (the facial nerve) that results in inability to control facial muscles on the affected side with weakness of the muscles of facial expression and eye closure. This can either be present in unilateral or bilateral form. Evidence: TAS. (OMIM:614688)
- Strabismus (HP:0000486): A misalignment of the eyes so that the visual axes deviate from bifoveal fixation. The classification of strabismus may be based on a number of features including the relative position of the eyes, whether the deviation is latent or manifest, intermittent or constant, concomitant or otherwise and according to the age of onset and the relevance of any associated refractive error. Evidence: TAS. (OMIM:614688)
- Dysmetria (HP:0001310): A type of ataxia characterized by the inability to carry out movements with the correct range and motion across the plane of more than one joint related to incorrect estimation of the distances required for targeted movements. Evidence: TAS. (OMIM:614688)
- Seizure (HP:0001250): A seizure is an intermittent abnormality of nervous system physiology characterized by a transient occurrence of signs and/or symptoms due to abnormal excessive or synchronous neuronal activity in the brain. Evidence: TAS. Frequency: Occasional (HP:0040283). (OMIM:614688)
- Hypotonia (HP:0001252): Hypotonia is an abnormally low muscle tone (the amount of tension or resistance to movement in a muscle). Even when relaxed, muscles have a continuous and passive partial contraction which provides some resistance to passive stretching. Hypotonia thus manifests as diminished resistance to passive stretching. Hypotonia is not the same as muscle weakness, although the two conditions can co-exist. Evidence: TAS. (OMIM:614688)
- Ataxia (HP:0001251): Ataxia refers to impaired coordination of voluntary muscle movement. Cerebellar ataxia refers to ataxia due to dysfunction of the cerebellum. This causes a variety of elementary neurological deficits including asynergy (lack of coordination between muscles, limbs and joints), dysmetria (lack of ability to judge distances that can lead to under- or overshoot in grasping movements), and dysdiadochokinesia (inability to perform rapid movements requiring antagonizing muscle groups to be switched on and off repeatedly). Evidence: TAS. (OMIM:614688)
- Generalized hypotonia (HP:0001290): Generalized muscular hypotonia (abnormally low muscle tone). Evidence: TAS. (OMIM:614688)
- Decreased corneal sensation (HP:0012155): Reduced ability of the cornea to respond to stimulation. Evidence: TAS. (OMIM:614688)
- Failure to thrive (HP:0001508): Failure to thrive (FTT) refers to a child whose physical growth is substantially below the norm. Evidence: TAS. (OMIM:614688)
- Nystagmus (HP:0000639): Rhythmic, involuntary oscillations of one or both eyes related to abnormality in fixation, conjugate gaze, or vestibular mechanisms. Evidence: TAS. (OMIM:614688)
- Hemivertebrae (HP:0002937): Absence of one half of the vertebral body. Evidence: TAS. (OMIM:614688)
- Oculomotor apraxia (HP:0000657): Ocular motor apraxia is a deficiency in voluntary, horizontal, lateral, fast eye movements (saccades) with retention of slow pursuit movements. The inability to follow objects visually is often compensated by head movements. There may be decreased smooth pursuit, and cancelation of the vestibulo-ocular reflex. Evidence: TAS. (OMIM:614688)
- Aspiration (HP:0002835): Inspiration of a foreign object into the airway. Evidence: TAS. (OMIM:614688)
- Sporadic (HP:0003745): Cases of the disease in question occur without a previous family history, i.e., as isolated cases without being transmitted from a parent and without other siblings being affected. Evidence: TAS. (OMIM:614688)
- Head titubation (HP:0002599): A head tremor of moderate speed (3 to 4 Hz) in the anterior-posterior direction. Evidence: TAS. (OMIM:614688)
- Intellectual disability (HP:0001249): The term intellectual disability or intellectual developmental disorder is used to describe significantly sub-average intellectual and adaptive functioning based on clinical assessment and as measured by individually administered, appropriately normed, standardized and validated tests of intellectual functioning and adaptive behavior, with onset during the developmental period from infancy through adolescence. Evidence: TAS. Frequency: Very frequent (HP:0040281). (OMIM:614688)
- Hyperreflexia (HP:0001347): Hyperreflexia is the presence of hyperactive stretch reflexes of the muscles. Evidence: PCS. Frequency: 3/3. (PMID:21651769)
- Dysphagia (HP:0002015): Difficulty in swallowing. Evidence: TAS. (OMIM:614688)
- Absent speech (HP:0001344): Complete lack of development of speech and language abilities. Evidence: TAS. (OMIM:614688)
- Scoliosis (HP:0002650): The presence of an abnormal lateral curvature of the spine. Evidence: TAS. (OMIM:614688)
- Abnormality of eye movement (HP:0000496): An abnormality in voluntary or involuntary eye movements or their control. Evidence: TAS. (OMIM:614688)
- Hypoplasia of the corpus callosum (HP:0002079): Underdevelopment of the corpus callosum. Evidence: TAS. Frequency: Occasional (HP:0040283). (OMIM:614688)
- Feeding difficulties (HP:0011968): Impaired ability to eat related to problems gathering food and getting ready to suck, chew, or swallow it. Evidence: TAS. (OMIM:614688)
- Global developmental delay (HP:0001263): A delay in the achievement of motor or mental milestones in the domains of development of a child, including motor skills, speech and language, cognitive skills, and social and emotional skills. This term should only be used to describe children younger than five years of age. Evidence: TAS. (OMIM:614688)
- Ankle clonus (HP:0011448): Clonus is an involuntary tendon reflex that causes repeated flexion and extension of the foot. Ankle clonus is tested by rapidly flexing the foot upward. Evidence: TAS. Frequency: Occasional (HP:0040283). (OMIM:614688)
- Rib fusion (HP:0000902): Complete or partial merging of adjacent ribs. Evidence: TAS. (OMIM:614688)
- Sensorineural hearing impairment (HP:0000407): A type of hearing impairment in one or both ears related to an abnormal functionality of the cochlear nerve. Evidence: TAS. (OMIM:614688)
- Ptosis (HP:0000508): The upper eyelid margin is positioned 3 mm or more lower than usual and covers the superior portion of the iris (objective); or, the upper lid margin obscures at least part of the pupil (subjective). Evidence: TAS. (OMIM:614688)
These phenotypes are associated with the disease pontine tegmental cap dysplasia (OMIM:614688).